- Abnormality of the dentition (HP:0000164): Any abnormality of the teeth. Evidence: PCS. Frequency: 0/4. (PMID:24714551)
- Congenital onset (HP:0003577): A phenotypic abnormality that is present at birth. Evidence: PCS. Frequency: 4/4. (PMID:24714551)
- Brittle hair (HP:0002299): Fragile, easily breakable hair, i.e., with reduced tensile strength. Evidence: PCS. Frequency: 4/4. (PMID:24714551)
- Alopecia (HP:0001596): A noncongenital process of hair loss, which may progress to partial or complete baldness. Evidence: IEA. (OMIM:614929)
- Sparse eyebrow (HP:0045075): Decreased density/number of eyebrow hairs. Evidence: PCS. Frequency: 4/4. (PMID:24714551)
- Dystrophic fingernails (HP:0008391): The presence of misshapen or partially destroyed nail plates, often with accumulation of soft, yellow keratin between the dystrophic nail plate and nail bed, resulting in elevation of the nail plate. Evidence: PCS. Frequency: 4/4. (PMID:24714551)
- Onycholysis (HP:0001806): Detachment of the nail from the nail bed. Evidence: PCS. Frequency: 4/4. (PMID:24714551)
- Sparse scalp hair (HP:0002209): Decreased number of hairs per unit area of skin of the scalp. Evidence: PCS. Frequency: 4/4. (PMID:24714551)
- Autosomal recessive inheritance (HP:0000007): A mode of inheritance that is observed for traits related to a gene encoded on one of the autosomes (i.e., the human chromosomes 1-22) in which a trait manifests in individuals with two pathogenic alleles, either homozygotes (two copies of the same mutant allele) or compound heterozygotes (whereby each copy of a gene has a distinct mutant allele). Evidence: PCS. (PMID:24714551)
- Sparse eyelashes (HP:0000653): Decreased density/number of eyelashes. Evidence: PCS. Frequency: 4/4. (PMID:24714551)
- Abnormal sweat gland morphology (HP:0000971): Any structural abnormality of the sweat gland. Evidence: PCS. Frequency: 0/4. (PMID:24714551)
- Dystrophic toenail (HP:0001810): Toenail changes apart from changes of the color of the toenail (nail dyschromia) that involve partial or complete disruption of the various keratinous layers of the nail plate. Evidence: PCS. Frequency: 4/4. (PMID:24714551)
- Abnormality of the skin (HP:0000951): An abnormality of the skin. Evidence: PCS. Frequency: 0/4. (PMID:24714551)
These phenotypes are associated with the disease ectodermal dysplasia 7, hair/nail type (OMIM:614929).